- Developmental cataract (HP:0000519): A cataract that occurs congenitally as the result of a developmental defect, in contrast to the majority of cataracts that occur in adulthood as the result of degenerative changes of the lens. Evidence: PCS. (PMID:21912254)
- Autosomal recessive inheritance (HP:0000007): A mode of inheritance that is observed for traits related to a gene encoded on one of the autosomes (i.e., the human chromosomes 1-22) in which a trait manifests in individuals with two pathogenic alleles, either homozygotes (two copies of the same mutant allele) or compound heterozygotes (whereby each copy of a gene has a distinct mutant allele). Evidence: TAS. (OMIM:116700)
These phenotypes are associated with the disease cataract 13 with adult I phenotype (OMIM:116700).